Phenotypes associated with the disease nephronophthisis 4 (OMIM:606966):
- Stage 5 chronic kidney disease (HP:0003774): A degree of kidney failure severe enough to require dialysis or kidney transplantation for survival characterized by a severe reduction in glomerular filtration rate (less than 15 ml/min/1.73 m2) and other manifestations including increased serum creatinine. Evidence: IEA. (OMIM:606966)
- Tubulointerstitial fibrosis (HP:0005576): A progressive detrimental connective tissue deposition (fibrosis) on the kidney parenchyma involving the tubules and interstitial tissue of the kidney. Tubulointerstitial injury in the kidney is complex, involving a number of independent and overlapping cellular and molecular pathways, with renal interstitial fibrosis and tubular atrophy (IF/TA) as the final common pathway. However, IF and TA are separable, as shown by the profound TA in renal artery stenosis, which characteristically has little or no fibrosis (or inflammation). For new annotations it is preferable to annotate to the specific HPO terms for Renal interstitial fibrosis and/or Renal tubular atrophy. Evidence: TAS. (OMIM:606966)
- Polydipsia (HP:0001959): Excessive thirst manifested by excessive fluid intake. Evidence: IEA. (OMIM:606966)
- Anemia (HP:0001903): A reduction in erythrocytes volume or hemoglobin concentration. Evidence: IEA. (OMIM:606966)
- Autosomal recessive inheritance (HP:0000007): A mode of inheritance that is observed for traits related to a gene encoded on one of the autosomes (i.e., the human chromosomes 1-22) in which a trait manifests in individuals with two pathogenic alleles, either homozygotes (two copies of the same mutant allele) or compound heterozygotes (whereby each copy of a gene has a distinct mutant allele). Evidence: IEA. (OMIM:606966)
- Nephronophthisis (HP:0000090): Presence of cysts at the corticomedullary junction of the kidney in combination with tubulointerstitial fibrosis. Evidence: IEA. (OMIM:606966)
- Renal corticomedullary cysts (HP:0000108): The presence of multiple cysts at the border between the renal cortex and medulla. Evidence: IEA. (OMIM:606966)
- Renal tubular atrophy (HP:0000092): The presence of renal tubules with thick redundant basement membranes, or a reduction of greater than 50% in tubular diameter compared to surrounding non-atrophic tubules. Evidence: IEA. (OMIM:606966)
- Polyuria (HP:0000103): An increased rate of urine production. Evidence: IEA. (OMIM:606966)
- Growth delay (HP:0001510): A deficiency or slowing down of growth pre- and postnatally. Evidence: IEA. (OMIM:606966)